- Uterus didelphys (HP:0003762): A malformation of the uterus in which the uterus is present as a paired organ as a result of the failure of fusion of the mullerian ducts during embryogenesis. Evidence: TAS. (OMIM:612229)
- Ureteral duplication (HP:0000073): A developmental anomaly characterized by the presence of two, instead of one, ureter connecting a kidney to the bladder. Evidence: TAS. (OMIM:612229)
These phenotypes are associated with the disease caudal duplication (OMIM:607864).